Phenotypes associated with the disease OCULAR DOMINANCE (OMIM:164190):
- Autosomal dominant inheritance (HP:0000006): A mode of inheritance that is observed for traits related to a gene encoded on one of the autosomes (i.e., the human chromosomes 1-22) in which a trait manifests in heterozygotes. In the context of medical genetics, an autosomal dominant disorder is caused when a single copy of the mutant allele is present. Males and females are affected equally, and can both transmit the disorder with a risk of 50% for each child of inheriting the mutant allele. Evidence: IEA. (OMIM:164190)